Phenotypes associated with the disease intellectual disability, autosomal recessive 66 (OMIM:618221):
- Epicanthus (HP:0000286): A fold of skin starting above the medial aspect of the upper eyelid and arching downward to cover, pass in front of and lateral to the medial canthus. Evidence: PCS. Frequency: 2/10. (PMID:27311568)
- Delayed speech and language development (HP:0000750): A degree of language development that is significantly below the norm for a child of a specified age. Evidence: PCS. Frequency: 10/10. (PMID:27311568)
- Joint hypermobility (HP:0001382): The capability that a joint (or a group of joints) has to move, passively and/or actively, beyond normal limits along physiological axes. Evidence: PCS. Frequency: 3/10. (PMID:27311568)
- Gait ataxia (HP:0002066): A type of ataxia characterized by the impairment of the ability to coordinate the movements required for normal walking. Gait ataxia is characteirzed by a wide-based staggering gait with a tendency to fall. Evidence: PCS. Frequency: 2/8. (PMID:27311568)
- Global developmental delay (HP:0001263): A delay in the achievement of motor or mental milestones in the domains of development of a child, including motor skills, speech and language, cognitive skills, and social and emotional skills. This term should only be used to describe children younger than five years of age. Evidence: PCS. Frequency: 1/1. (PMID:25558065)
- Hypotonia (HP:0001252): Hypotonia is an abnormally low muscle tone (the amount of tension or resistance to movement in a muscle). Even when relaxed, muscles have a continuous and passive partial contraction which provides some resistance to passive stretching. Hypotonia thus manifests as diminished resistance to passive stretching. Hypotonia is not the same as muscle weakness, although the two conditions can co-exist. Evidence: PCS. Frequency: 2/10. (PMID:27311568)
- Generalized hypotonia (HP:0001290): Generalized muscular hypotonia (abnormally low muscle tone). Evidence: IEA. (OMIM:618221)
- Excessive shyness (HP:0100962): Atypically high degree of awkwardness or apprehension experienced when approaching or being approached by others. Evidence: PCS. Frequency: 2/8. (PMID:27311568)
- Aggressive behavior (HP:0000718): Behavior or an act aimed at harming a person, animal, or physical property (e.g., acts of physical violence; shouting, swearing, and using harsh language; slashing someone's tires). Evidence: PCS. Frequency: 2/8. (PMID:27311568)
- Autistic behavior (HP:0000729): Persistent deficits in social interaction and communication and interaction as well as a markedly restricted repertoire of activity and interest as well as repetitive patterns of behavior. Evidence: PCS. Frequency: 2/8. (PMID:27311568)
- Abnormal facial shape (HP:0001999): An abnormal morphology (form) of the face or its components. Evidence: PCS. Frequency: 3/10. (PMID:27311568)
- Autosomal recessive inheritance (HP:0000007): A mode of inheritance that is observed for traits related to a gene encoded on one of the autosomes (i.e., the human chromosomes 1-22) in which a trait manifests in individuals with two pathogenic alleles, either homozygotes (two copies of the same mutant allele) or compound heterozygotes (whereby each copy of a gene has a distinct mutant allele). Evidence: PCS. (PMID:27311568)
- Attention deficit hyperactivity disorder (HP:0007018): Attention deficit hyperactivity disorder (ADHD) manifests at age 2-3 years or by first grade at the latest. The main symptoms are distractibility, impulsivity, hyperactivity, and often trouble organizing tasks and projects, difficulty going to sleep, and social problems from being aggressive, loud, or impatient. Evidence: PCS. Frequency: 1/1. (PMID:25558065)
- Intellectual disability (HP:0001249): The term intellectual disability or intellectual developmental disorder is used to describe significantly sub-average intellectual and adaptive functioning based on clinical assessment and as measured by individually administered, appropriately normed, standardized and validated tests of intellectual functioning and adaptive behavior, with onset during the developmental period from infancy through adolescence. Evidence: PCS. Frequency: 13/13. (PMID:28097321;PMID:27311568;PMID:25558065)